- Dysarthria (HP:0001260): Dysarthric speech is a general description referring to a neurological speech disorder characterized by poor articulation. Depending on the involved neurological structures, dysarthria may be further classified as spastic, flaccid, ataxic, hyperkinetic and hypokinetic, or mixed. Evidence: TAS. Frequency: Very frequent (HP:0040281). (ORPHA:228169)
- Gait disturbance (HP:0001288): The term gait disturbance can refer to any disruption of the ability to walk. Evidence: TAS. Frequency: Frequent (HP:0040282). (ORPHA:228169)
- Dysphagia (HP:0002015): Difficulty in swallowing. Evidence: TAS. Frequency: Frequent (HP:0040282). (ORPHA:228169)
- Rigidity (HP:0002063): Continuous involuntary sustained muscle contraction. When an affected muscle is passively stretched, the degree of resistance remains constant regardless of the rate at which the muscle is stretched. This feature helps to distinguish rigidity from muscle spasticity. Evidence: TAS. Frequency: Very frequent (HP:0040281). (ORPHA:228169)
- Bradykinesia (HP:0002067): Bradykinesia literally means slow movement, and is used clinically to denote a slowness in the execution of movement (in contrast to hypokinesia, which is used to refer to slowness in the initiation of movement). Evidence: TAS. Frequency: Very frequent (HP:0040281). (ORPHA:228169)
- Dysdiadochokinesis (HP:0002075): A type of ataxia characterized by the impairment of the ability to perform rapidly alternating movements, such as pronating and supinating his or her hand on the dorsum of the other hand as rapidly as possible. Evidence: TAS. Frequency: Very frequent (HP:0040281). (ORPHA:228169)
- Abnormality of movement (HP:0100022): An abnormality of movement with a neurological basis characterized by changes in coordination and speed of voluntary movements. Evidence: TAS. Frequency: Very frequent (HP:0040281). (ORPHA:228169)
These phenotypes are associated with the disease Autosomal dominant striatal neurodegeneration (ORPHA:228169).